- Portal hypertension (HP:0001409): Increased pressure in the portal vein. Evidence: PCS. Frequency: 1/3. (PMID:23972370)
- Telangiectasia (HP:0001009): Telangiectasias refer to small dilated blood vessels located near the surface of the skin or mucous membranes, measuring between 0.5 and 1 millimeter in diameter. Telangiectasia are located especially on the tongue, lips, palate, fingers, face, conjunctiva, trunk, nail beds, and fingertips. Evidence: PCS. Frequency: 3/3. (PMID:23972370)
- Spontaneous, recurrent epistaxis (HP:0004406). Evidence: PCS. Frequency: 3/3. (PMID:23972370)
- Elevated circulating hepatic transaminase concentration (HP:0002910): Elevations of the levels of SGOT and SGPT in the serum. SGOT (serum glutamic oxaloacetic transaminase) and SGPT (serum glutamic pyruvic transaminase) are transaminases primarily found in the liver and heart and are released into the bloodstream as the result of liver or heart damage. SGOT and SGPT are used clinically mainly as markers of liver damage. Evidence: PCS. Frequency: 1/3. (PMID:23972370)
- Autosomal dominant inheritance (HP:0000006): A mode of inheritance that is observed for traits related to a gene encoded on one of the autosomes (i.e., the human chromosomes 1-22) in which a trait manifests in heterozygotes. In the context of medical genetics, an autosomal dominant disorder is caused when a single copy of the mutant allele is present. Males and females are affected equally, and can both transmit the disorder with a risk of 50% for each child of inheriting the mutant allele. Evidence: PCS. (PMID:23972370)
These phenotypes are associated with the disease telangiectasia, hereditary hemorrhagic, type 5 (OMIM:615506).